Phenotypes associated with the disease intellectual disability, X-linked 50 (OMIM:300115):
- Mild intellectual disability (HP:0001256): Mild intellectual disability (ID) is defined as a type of ID characterized by mildly sub-average adaptive functioning and intellectual functioning, with an intelligence quotient (IQ) the range of 50-69. Evidence: IEA. (OMIM:300115)
- X-linked inheritance (HP:0001417): A mode of inheritance that is observed for traits related to a gene encoded on the X chromosome. Evidence: IEA. (OMIM:300115)